- Elevated erythrocyte sedimentation rate (HP:0003565): An increased erythrocyte sedimentation rate (ESR). The ESR is a test that measures the distance that erythrocytes have fallen after one hour in a vertical column of anticoagulated blood under the influence of gravity. The ESR is a nonspecific finding. An elevation may indicate inflammation or may be caused by any condition that elevates fibrinogen. Evidence: PCS. Frequency: 1/1. (PMID:33674380)
- Ulcerative colitis (HP:0100279): A chronic inflammatory bowel disease that includes characteristic ulcers, or open sores, in the colon. The main symptom of active disease is usually constant diarrhea mixed with blood, of gradual onset and intermittent periods of exacerbated symptoms contrasting with periods that are relatively symptom-free. In contrast to Crohn's disease this special form of colitis begins in the distal parts of the rectum, spreads continually upwards and affects only mucose and submucose tissue of the colon. Evidence: PCS. Frequency: 1/1. (PMID:33674380)
- Anemia (HP:0001903): A reduction in erythrocytes volume or hemoglobin concentration. Evidence: PCS. Frequency: 1/1. (PMID:33674380)
- Infantile onset (HP:0003593): Onset of signs or symptoms of disease between 28 days to one year of life. Evidence: PCS. Frequency: 1/1. (PMID:33674380)
- Autosomal recessive inheritance (HP:0000007): A mode of inheritance that is observed for traits related to a gene encoded on one of the autosomes (i.e., the human chromosomes 1-22) in which a trait manifests in individuals with two pathogenic alleles, either homozygotes (two copies of the same mutant allele) or compound heterozygotes (whereby each copy of a gene has a distinct mutant allele). Evidence: PCS. (PMID:33674380)
- Motor delay (HP:0001270): A type of Developmental delay characterized by a delay in acquiring motor skills. Evidence: PCS. Frequency: 1/1. (PMID:33674380)
- Bloody diarrhea (HP:0025085): Passage of many stools containing blood. Evidence: PCS. Frequency: 1/1. (PMID:33674380)
- Elevated circulating C-reactive protein concentration (HP:0011227): The concentration of C-reactive protein in the blood circulation is above the upper limit of normal. Evidence: PCS. Frequency: 1/1. (PMID:33674380)
- Increased total leukocyte count (HP:0001974): An abnormal increase in the number of leukocytes in the blood. Evidence: PCS. Frequency: 1/1. (PMID:33674380)
These phenotypes are associated with the disease inflammatory bowel disease (infantile ulcerative colitis) 31, autosomal recessive (OMIM:619398).